- Pituitary growth hormone cell adenoma (HP:0011760): A type of pituitary adenoma that produces growth hormone. Evidence: TAS. (OMIM:617686)
- Increased circulating prolactin concentration (HP:0000870): The presence of abnormally increased levels of prolactin in the blood. Prolactin is a peptide hormone produced by the anterior pituitary gland that plays a role in breast development and lactation during pregnancy. Evidence: TAS. (OMIM:617686)
- Typified by somatic mosaicism (HP:0001442): Description of conditions in which affected individuals typically display somatic mosaicism, i.e., genetically distinct populations of somatic cells in a given organism caused by DNA mutations, epigenetic alterations of DNA, chromosomal abnormalities or the spontaneous reversion of inherited mutations. In many conditions typified by somatic mosaicism, constitutive mutation is lethal and cases are exclusively or predominantly mosaic. Evidence: TAS. (OMIM:617686)
- Increased circulating ACTH level (HP:0003154): An abnormal increased in the concentration of corticotropin, also known as adrenocorticotropic hormone (ACTH), in the blood. Evidence: TAS. (OMIM:617686)
- Acral overgrowth (HP:0033794): Excessive growth of hands and feet (predominantly due to soft tissue swelling). Typical manifestations include shoe size increase, foot enlargement, glove tightness, and hand enlargement. Evidence: TAS. (OMIM:617686)
- Hyperpigmentation of the skin (HP:0000953): A darkening of the skin related to an increase in melanin production and deposition. Evidence: TAS. (OMIM:617686)
- Elevated circulating growth hormone concentration (HP:0000845): Acromegaly is a condition resulting from overproduction of growth hormone by the pituitary gland in persons with closed epiphyses, and consists chiefly in the enlargement of the distal parts of the body. The circumference of the skull increases, the nose becomes broad, the tongue becomes enlarged, the facial features become coarsened, the mandible grows excessively, and the teeth become separated. The fingers and toes grow chiefly in thickness. Evidence: TAS. (OMIM:617686)
- Increased circulating cortisol level (HP:0003118): Overproduction of the hormone of cortisol by the adrenal cortex, resulting in a characteristic combination of clinical symptoms termed Cushing syndrome, with truncal obesity, a round, full face, striae atrophicae and acne, muscle weakness, and other features. Evidence: TAS. (OMIM:617686)
- Pituitary corticotropic cell adenoma (HP:0008291): A type of pituitary adenoma that produces adrenocorticotropic hormone (ACTH). Evidence: TAS. (OMIM:617686)
These phenotypes are associated with the disease pituitary adenoma 3, multiple types (OMIM:617686).